Phenotypes associated with the disease autosomal dominant nonsyndromic hearing loss 30 (OMIM:606451):
- Sensorineural hearing impairment (HP:0000407): A type of hearing impairment in one or both ears related to an abnormal functionality of the cochlear nerve. Evidence: PCS. (PMID:11571554)
- Autosomal dominant inheritance (HP:0000006): A mode of inheritance that is observed for traits related to a gene encoded on one of the autosomes (i.e., the human chromosomes 1-22) in which a trait manifests in heterozygotes. In the context of medical genetics, an autosomal dominant disorder is caused when a single copy of the mutant allele is present. Males and females are affected equally, and can both transmit the disorder with a risk of 50% for each child of inheriting the mutant allele. Evidence: PCS. (PMID:11571554)